- Esophagitis (HP:0100633): Inflammation of the esophagus. Evidence: TAS. (OMIM:613412)
- Dysphagia (HP:0002015): Difficulty in swallowing. Evidence: TAS. (OMIM:613412)
- Increased total eosinophil count (HP:0001880): Increased count of eosinophils in the blood. Evidence: IEA. (OMIM:613412)
- Vomiting (HP:0002013): Forceful ejection of the contents of the stomach through the mouth by means of a series of involuntary spasmic contractions. Evidence: TAS. (OMIM:613412)
- Failure to thrive (HP:0001508): Failure to thrive (FTT) refers to a child whose physical growth is substantially below the norm. Evidence: TAS. (OMIM:613412)
- Epigastric pain (HP:0410019): Pain that is localized to the region of the upper abdomen immediately below the ribs. Evidence: TAS. (OMIM:613412)
These phenotypes are associated with the disease esophagitis, eosinophilic, 2 (OMIM:613412).